- Cataract (HP:0000518): A cataract is an opacity or clouding that develops in the crystalline lens of the eye or in its capsule. Evidence: IEA. (OMIM:106230)
- Microcornea (HP:0000482): A congenital abnormality of the cornea in which the cornea and the anterior segment of the eye are smaller than normal. The horizontal diameter of the cornea does not reach 10 mm even in adulthood. Evidence: TAS. (OMIM:106230)
- Aniridia (HP:0000526): Abnormality of the iris characterized by, typically bilateral, complete or partial iris hypoplasia. The phenotype ranges from mild defects of anterior iris stroma only to almost complete absence of the iris. Evidence: TAS. (OMIM:106230)
- Autosomal dominant inheritance (HP:0000006): A mode of inheritance that is observed for traits related to a gene encoded on one of the autosomes (i.e., the human chromosomes 1-22) in which a trait manifests in heterozygotes. In the context of medical genetics, an autosomal dominant disorder is caused when a single copy of the mutant allele is present. Males and females are affected equally, and can both transmit the disorder with a risk of 50% for each child of inheriting the mutant allele. Evidence: TAS. (OMIM:106230)
These phenotypes are associated with the disease aniridia, microcornea, and spontaneously Reabsorbed cataract (OMIM:106230).